Phenotypes associated with the disease Autosomal recessive chorioretinopathy-microcephaly syndrome (ORPHA:2518):
- Microcephaly (HP:0000252): Head circumference below 2 standard deviations below the mean for age and gender. Evidence: TAS. Frequency: Very frequent (HP:0040281). (ORPHA:2518)
- Pointed chin (HP:0000307): A marked tapering of the lower face to the chin. Evidence: TAS. Frequency: Frequent (HP:0040282). (ORPHA:2518)
- Sloping forehead (HP:0000340): Inclination of the anterior surface of the forehead from the vertical more than two standard deviations above the mean (objective); or apparently excessive posterior sloping of the forehead in a lateral view. Evidence: TAS. Frequency: Frequent (HP:0040282). (ORPHA:2518)
- Protruding ear (HP:0000411): Angle formed by the plane of the ear and the mastoid bone greater than the 97th centile for age (objective); or, outer edge of the helix more than 2 cm from the mastoid at the point of maximum distance (objective). Evidence: TAS. Frequency: Frequent (HP:0040282). (ORPHA:2518)
- Wide nasal bridge (HP:0000431): Increased breadth of the nasal bridge (and with it, the nasal root). Evidence: TAS. Frequency: Frequent (HP:0040282). (ORPHA:2518)
- Anteverted nares (HP:0000463): Anteriorly-facing nostrils viewed with the head in the Frankfurt horizontal and the eyes of the observer level with the eyes of the subject. This gives the appearance of an upturned nose (upturned nasal tip). Evidence: TAS. Frequency: Frequent (HP:0040282). (ORPHA:2518)
- Strabismus (HP:0000486): A misalignment of the eyes so that the visual axes deviate from bifoveal fixation. The classification of strabismus may be based on a number of features including the relative position of the eyes, whether the deviation is latent or manifest, intermittent or constant, concomitant or otherwise and according to the age of onset and the relevance of any associated refractive error. Evidence: TAS. Frequency: Frequent (HP:0040282). (ORPHA:2518)
- Abnormal eyelash morphology (HP:0000499): An abnormality of the eyelashes. Evidence: TAS. Frequency: Frequent (HP:0040282). (ORPHA:2518)
- Visual impairment (HP:0000505): Visual impairment (or vision impairment) is vision loss (of a person) to such a degree as to qualify as an additional support need through a significant limitation of visual capability resulting from either disease, trauma, or congenital or degenerative conditions that cannot be corrected by conventional means, such as refractive correction, medication, or surgery. Evidence: TAS. Frequency: Frequent (HP:0040282). (ORPHA:2518)
- Nystagmus (HP:0000639): Rhythmic, involuntary oscillations of one or both eyes related to abnormality in fixation, conjugate gaze, or vestibular mechanisms. Evidence: TAS. Frequency: Frequent (HP:0040282). (ORPHA:2518)
- Optic atrophy (HP:0000648): Atrophy of the optic nerve. Optic atrophy results from the death of the retinal ganglion cell axons that comprise the optic nerve and manifesting as a pale optic nerve on fundoscopy. Evidence: TAS. Frequency: Frequent (HP:0040282). (ORPHA:2518)
- Intellectual disability (HP:0001249): The term intellectual disability or intellectual developmental disorder is used to describe significantly sub-average intellectual and adaptive functioning based on clinical assessment and as measured by individually administered, appropriately normed, standardized and validated tests of intellectual functioning and adaptive behavior, with onset during the developmental period from infancy through adolescence. Evidence: TAS. Frequency: Frequent (HP:0040282). (ORPHA:2518)
- Seizure (HP:0001250): A seizure is an intermittent abnormality of nervous system physiology characterized by a transient occurrence of signs and/or symptoms due to abnormal excessive or synchronous neuronal activity in the brain. Evidence: TAS. Frequency: Frequent (HP:0040282). (ORPHA:2518)
- Hypertonia (HP:0001276): A condition in which there is increased muscle tone so that arms or legs, for example, are stiff and difficult to move. Evidence: TAS. Frequency: Frequent (HP:0040282). (ORPHA:2518)
- Intrauterine growth retardation (HP:0001511): An abnormal restriction of fetal growth with fetal weight below the tenth percentile for gestational age. Evidence: TAS. Frequency: Frequent (HP:0040282). (ORPHA:2518)
- Cerebral cortical atrophy (HP:0002120): Atrophy of the cortex of the cerebrum. Evidence: TAS. Frequency: Frequent (HP:0040282). (ORPHA:2518)
- Abnormality of neuronal migration (HP:0002269): An abnormality resulting from an anomaly of neuronal migration, i.e., of the process by which neurons travel from their origin to their final position in the brain. Evidence: TAS. Frequency: Frequent (HP:0040282). (ORPHA:2518)
- Scoliosis (HP:0002650): The presence of an abnormal lateral curvature of the spine. Evidence: TAS. Frequency: Frequent (HP:0040282). (ORPHA:2518)
- Short stature (HP:0004322): A height below that which is expected according to age and gender norms. Although there is no universally accepted definition of short stature, many refer to "short stature" as height more than 2 standard deviations below the mean for age and gender (or below the 3rd percentile for age and gender dependent norms). Evidence: TAS. Frequency: Frequent (HP:0040282). (ORPHA:2518)
- Biparietal narrowing (HP:0004422): A narrowing of the biparietal diameter (i.e., of the transverse distance between the protuberances of the two parietal bones of the skull). Evidence: TAS. Frequency: Frequent (HP:0040282). (ORPHA:2518)
- Aplasia/Hypoplasia of the cerebellum (HP:0007360). Evidence: TAS. Frequency: Frequent (HP:0040282). (ORPHA:2518)
- Abnormal retinal pigmentation (HP:0007703): Any deviation from the normal pigmentation of the retina. Evidence: TAS. Frequency: Very frequent (HP:0040281). (ORPHA:2518)